- Hypertonia (HP:0001276): A condition in which there is increased muscle tone so that arms or legs, for example, are stiff and difficult to move. Evidence: IEA. (OMIM:610623)
- Congenital onset (HP:0003577): A phenotypic abnormality that is present at birth. Evidence: PCS. Frequency: 2/2. (PMID:9620774)
- Cataract (HP:0000518): A cataract is an opacity or clouding that develops in the crystalline lens of the eye or in its capsule. Evidence: IEA. (OMIM:610623)
- Blindness (HP:0000618): Blindness is the condition of lacking visual perception defined as a profound reduction in visual perception. On the 6m visual acuity scale, blindness is defined as less than 3/60. On the 20ft visual acuity scale, blindness is defined as less than 20/400. On the decimal visual acuity scale, blindness is defined as less than 0.05. Blindness is typically characterized by a visual field of no greater than 10 degrees in radius around central fixation. Evidence: IEA. (OMIM:610623)
- Developmental cataract (HP:0000519): A cataract that occurs congenitally as the result of a developmental defect, in contrast to the majority of cataracts that occur in adulthood as the result of degenerative changes of the lens. Evidence: PCS. Frequency: 2/2. Onset: Congenital onset (HP:0003577). (PMID:9620774)
- Chorea (HP:0002072): Chorea (Greek for 'dance') refers to widespread arrhythmic involuntary movements of a forcible, jerky and restless fashion. It is a random-appearing sequence of one or more discrete involuntary movements or movement fragments. Movements appear random because of variability in timing, duration or location. Each movement may have a distinct start and end. However, movements may be strung together and thus may appear to flow randomly from one muscle group to another. Chorea can involve the trunk, neck, face, tongue, and extremities. Evidence: IEA. (OMIM:610623)
- Microphthalmia (HP:0000568): A developmental anomaly characterized by abnormal smallness of one or both eyes. Evidence: IEA. (OMIM:610623)
- Autosomal recessive inheritance (HP:0000007): A mode of inheritance that is observed for traits related to a gene encoded on one of the autosomes (i.e., the human chromosomes 1-22) in which a trait manifests in individuals with two pathogenic alleles, either homozygotes (two copies of the same mutant allele) or compound heterozygotes (whereby each copy of a gene has a distinct mutant allele). Evidence: IEA. (OMIM:610623)
- Autosomal dominant inheritance (HP:0000006): A mode of inheritance that is observed for traits related to a gene encoded on one of the autosomes (i.e., the human chromosomes 1-22) in which a trait manifests in heterozygotes. In the context of medical genetics, an autosomal dominant disorder is caused when a single copy of the mutant allele is present. Males and females are affected equally, and can both transmit the disorder with a risk of 50% for each child of inheriting the mutant allele. Evidence: PCS. (PMID:9620774)
- Diminished deep tendon reflex (HP:0001315): A reduction (hyporeflexia) or complete absence (areflexia) of the involuntary muscle contraction normally elicited by a reflex stimulus, such as tapping a deep tendon. Evidence: IEA. (OMIM:610623)
- Intellectual disability (HP:0001249): The term intellectual disability or intellectual developmental disorder is used to describe significantly sub-average intellectual and adaptive functioning based on clinical assessment and as measured by individually administered, appropriately normed, standardized and validated tests of intellectual functioning and adaptive behavior, with onset during the developmental period from infancy through adolescence. Evidence: IEA. (OMIM:610623)
These phenotypes are associated with the disease cataract 11 multiple types (OMIM:610623).